- Increased carotid artery intimal medial thickness (HP:0012273): An increase in the combined thickness of the intima and media of the carotid artery. Evidence: TAS. (OMIM:609338)
- Polygenic inheritance (HP:0010982): A mode of inheritance that depends on a mixture of major and minor genetic determinants possibly together with environmental factors. Diseases inherited in this manner are termed complex diseases. Evidence: TAS. (OMIM:609338)
These phenotypes are associated with the disease Carotid intimal medial thickness 1 (OMIM:609338).